- Progressive cerebellar ataxia (HP:0002073). Evidence: TAS. Frequency: Very frequent (HP:0040281). (ORPHA:284332)
- Delayed speech and language development (HP:0000750): A degree of language development that is significantly below the norm for a child of a specified age. Evidence: TAS. Frequency: Frequent (HP:0040282). (ORPHA:284332)
- Spasticity (HP:0001257): A motor disorder characterized by a velocity-dependent increase in tonic stretch reflexes with increased muscle tone, exaggerated (hyperexcitable) tendon reflexes. Evidence: TAS. Frequency: Frequent (HP:0040282). (ORPHA:284332)
- Dysarthria (HP:0001260): Dysarthric speech is a general description referring to a neurological speech disorder characterized by poor articulation. Depending on the involved neurological structures, dysarthria may be further classified as spastic, flaccid, ataxic, hyperkinetic and hypokinetic, or mixed. Evidence: TAS. Frequency: Frequent (HP:0040282). (ORPHA:284332)
- Global developmental delay (HP:0001263): A delay in the achievement of motor or mental milestones in the domains of development of a child, including motor skills, speech and language, cognitive skills, and social and emotional skills. This term should only be used to describe children younger than five years of age. Evidence: TAS. Frequency: Frequent (HP:0040282). (ORPHA:284332)
- Cerebellar atrophy (HP:0001272): Cerebellar atrophy is defined as a cerebellum with initially normal structures, in a posterior fossa with normal size, which displays enlarged fissures (interfolial spaces) in comparison to the foliae secondary to loss of tissue. Cerebellar atrophy implies irreversible loss of tissue and result from an ongoing progressive disease until a final stage is reached or a single injury, e.g. an intoxication or infectious event. Evidence: TAS. Frequency: Frequent (HP:0040282). (ORPHA:284332)
- Gait disturbance (HP:0001288): The term gait disturbance can refer to any disruption of the ability to walk. Evidence: TAS. Frequency: Frequent (HP:0040282). (ORPHA:284332)
- Generalized hypotonia (HP:0001290): Generalized muscular hypotonia (abnormally low muscle tone). Evidence: TAS. Frequency: Frequent (HP:0040282). (ORPHA:284332)
- Dysmetria (HP:0001310): A type of ataxia characterized by the inability to carry out movements with the correct range and motion across the plane of more than one joint related to incorrect estimation of the distances required for targeted movements. Evidence: TAS. Frequency: Frequent (HP:0040282). (ORPHA:284332)
- Hyperreflexia (HP:0001347): Hyperreflexia is the presence of hyperactive stretch reflexes of the muscles. Evidence: TAS. Frequency: Frequent (HP:0040282). (ORPHA:284332)
- Pes planus (HP:0001763): A foot where the longitudinal arch of the foot is in contact with the ground or floor when the individual is standing; or, in a patient lying supine, a foot where the arch is in contact with the surface of a flat board pressed against the sole of the foot by the examiner with a pressure similar to that expected from weight bearing; or, the height of the arch is reduced. Evidence: TAS. Frequency: Frequent (HP:0040282). (ORPHA:284332)
- Broad-based gait (HP:0002136): An abnormal gait pattern in which persons stand and walk with their feet spaced widely apart. This is often a component of cerebellar ataxia. Evidence: TAS. Frequency: Frequent (HP:0040282). (ORPHA:284332)
- Clumsiness (HP:0002312): Lack of physical coordination resulting in an abnormal tendency to drop items or bump into objects. Evidence: TAS. Frequency: Frequent (HP:0040282). (ORPHA:284332)
- Babinski sign (HP:0003487): Upturning of the big toe (and sometimes fanning of the other toes) in response to stimulation of the sole of the foot. If the Babinski sign is present it can indicate damage to the corticospinal tract. Evidence: TAS. Frequency: Frequent (HP:0040282). (ORPHA:284332)
- Short stature (HP:0004322): A height below that which is expected according to age and gender norms. Although there is no universally accepted definition of short stature, many refer to "short stature" as height more than 2 standard deviations below the mean for age and gender (or below the 3rd percentile for age and gender dependent norms). Evidence: TAS. Frequency: Frequent (HP:0040282). (ORPHA:284332)
- Cerebellar vermis atrophy (HP:0006855): Wasting (atrophy) of the vermis of cerebellum. Evidence: TAS. Frequency: Frequent (HP:0040282). (ORPHA:284332)
- Progressive gait ataxia (HP:0007240): A type of gait ataxia displaying progression of clinical severity. Evidence: TAS. Frequency: Frequent (HP:0040282). (ORPHA:284332)
- Intention tremor (HP:0002080): A type of kinetic tremor that occurs during target directed movement is called intention tremor. That is, an oscillatory cerebellar ataxia that tends to be absent when the limbs are inactive and during the first part of voluntary movement but worsening as the movement continues and greater precision is required (e.g., in touching a target such as the patient's nose or a physician's finger). Evidence: TAS. Frequency: Occasional (HP:0040283). (ORPHA:284332)
These phenotypes are associated with the disease Infantile-onset autosomal recessive nonprogressive cerebellar ataxia (ORPHA:284332).